- Pallor (HP:0000980): Abnormally pale skin. Evidence: TAS. Frequency: Very frequent (HP:0040281). (ORPHA:544482)
- Thrombocytopenia (HP:0001873): A reduction in the number of circulating thrombocytes. Evidence: TAS. Frequency: Very frequent (HP:0040281). (ORPHA:544482)
- Hemolytic anemia (HP:0001878): A type of anemia caused by premature destruction of red blood cells (hemolysis). Evidence: TAS. Frequency: Very frequent (HP:0040281). (ORPHA:544482)
- Acute kidney injury (HP:0001919): Sudden loss of renal function, as manifested by decreased urine production, and a rise in serum creatinine or blood urea nitrogen concentration (azotemia). Evidence: TAS. Frequency: Very frequent (HP:0040281). (ORPHA:544482)
- Fatigue (HP:0012378): A subjective feeling of tiredness characterized by a lack of energy and motivation. Evidence: TAS. Frequency: Very frequent (HP:0040281). (ORPHA:544482)
- Severe infection (HP:0032169): A type of infection that is regarded as a sign of a pathological susceptibility to infection because of unusual severity or intensity of the infection. Evidence: TAS. Frequency: Very frequent (HP:0040281). (ORPHA:544482)
- Abnormality of the nervous system (HP:0000707): An abnormality of the nervous system. Evidence: TAS. Frequency: Frequent (HP:0040282). (ORPHA:544482)
- Fever (HP:0001945): Body temperature elevated above the normal range. Evidence: TAS. Frequency: Frequent (HP:0040282). (ORPHA:544482)
- Increased total leukocyte count (HP:0001974): An abnormal increase in the number of leukocytes in the blood. Evidence: TAS. Frequency: Frequent (HP:0040282). (ORPHA:544482)
- Diarrhea (HP:0002014): Abnormally increased frequency (usually defined as three or more) loose or watery bowel movements a day. Evidence: TAS. Frequency: Frequent (HP:0040282). (ORPHA:544482)
- Abdominal pain (HP:0002027): An unpleasant sensation characterized by physical discomfort (such as pricking, throbbing, or aching) and perceived to originate in the abdomen. Evidence: TAS. Frequency: Frequent (HP:0040282). (ORPHA:544482)
- Decreased urine output (HP:0011037): A decreased rate of urine production. Evidence: TAS. Frequency: Frequent (HP:0040282). (ORPHA:544482)
- Abnormal circulating chemokine concentration (HP:0011115): An abnormality in the production or cellular release of a chemokine (a class of cytokines). Evidence: TAS. Frequency: Frequent (HP:0040282). (ORPHA:544482)
- Abnormal circulating interferon concentration (HP:0011116): The concentration of an interferon is outside the limits of normal. Evidence: TAS. Frequency: Frequent (HP:0040282). (ORPHA:544482)
- Respiratory tract infection (HP:0011947): An infection of the upper or lower respiratory tract. Evidence: TAS. Frequency: Frequent (HP:0040282). (ORPHA:544482)
- Increased circulating interleukin 6 concentration (HP:0030783): The concentration of interleukin-6 in the blood circulation is above the upper limit of normal. Evidence: TAS. Frequency: Frequent (HP:0040282). (ORPHA:544482)
- Abdominal cramps (HP:0032155): A type of abdominal pain characterized by a feeling of contractions and typically fluctuating in intensity. Evidence: TAS. Frequency: Frequent (HP:0040282). (ORPHA:544482)
- Acute colitis (HP:0100282): An acute and self-limited inflammatory disease of the large intestine (colon, cecum and rectum). Evidence: TAS. Frequency: Frequent (HP:0040282). (ORPHA:544482)
- Hypertension (HP:0000822): The presence of chronic increased pressure in the systemic arterial system. Evidence: TAS. Frequency: Occasional (HP:0040283). (ORPHA:544482)
- Edema (HP:0000969): An abnormal accumulation of fluid beneath the skin, or in one or more cavities of the body. Evidence: TAS. Frequency: Occasional (HP:0040283). (ORPHA:544482)
- Meningitis (HP:0001287): Inflammation of the meninges. Evidence: TAS. Frequency: Occasional (HP:0040283). (ORPHA:544482)
- Pancreatitis (HP:0001733): The presence of inflammation in the pancreas. Evidence: TAS. Frequency: Occasional (HP:0040283). (ORPHA:544482)
- Vomiting (HP:0002013): Forceful ejection of the contents of the stomach through the mouth by means of a series of involuntary spasmic contractions. Evidence: TAS. Frequency: Occasional (HP:0040283). (ORPHA:544482)
- Nausea (HP:0002018): A sensation of unease in the stomach together with an urge to vomit. Evidence: TAS. Frequency: Occasional (HP:0040283). (ORPHA:544482)
- Pneumonia (HP:0002090): Inflammation of any part of the lung parenchyma. Evidence: TAS. Frequency: Occasional (HP:0040283). (ORPHA:544482)
- Dyspnea (HP:0002094): Difficult or labored breathing. Dyspnea is a subjective feeling only the patient can rate, e.g., on a Borg scale. Evidence: TAS. Frequency: Occasional (HP:0040283). (ORPHA:544482)
- Pleuritis (HP:0002102): Inflammation of the pleura. Evidence: TAS. Frequency: Occasional (HP:0040283). (ORPHA:544482)
- Hyperkalemia (HP:0002153): The concentration of potassium(1+) in the blood circulation is above the upper limit of normal. Evidence: TAS. Frequency: Occasional (HP:0040283). (ORPHA:544482)
- Hypocalcemia (HP:0002901): The concentration of calcium in the blood circulation is below the lower limit of normal. Evidence: TAS. Frequency: Occasional (HP:0040283). (ORPHA:544482)
- Hyponatremia (HP:0002902): The concentration of sodium in the blood circulation is below the lower limit of normal. Evidence: TAS. Frequency: Occasional (HP:0040283). (ORPHA:544482)
- Reduced consciousness (HP:0004372): Abnormally diminished level of attention, responsiveness, or wakefulness. Evidence: TAS. Frequency: Occasional (HP:0040283). (ORPHA:544482)
- Secretory diarrhea (HP:0005208): Watery voluminous diarrhea resulting from an imbalance between ion and water secretion and absorption. Evidence: TAS. Frequency: Occasional (HP:0040283). (ORPHA:544482)
- Nephrotic range proteinuria (HP:0012593): Severely increased amount of excretion of protein in the urine, defined as 3.5 grams per day or more in adults and 40 mg per meter-squared body surface area per hour in children. Evidence: TAS. Frequency: Occasional (HP:0040283). (ORPHA:544482)
- Myocarditis (HP:0012819): Inflammation of the myocardium. Evidence: TAS. Frequency: Occasional (HP:0040283). (ORPHA:544482)
- Bloody diarrhea (HP:0025085): Passage of many stools containing blood. Evidence: TAS. Frequency: Occasional (HP:0040283). (ORPHA:544482)
- Severe viral infection (HP:0031691): An unusually severe viral infection. Evidence: TAS. Frequency: Occasional (HP:0040283). (ORPHA:544482)
- Bacteremia (HP:0031864): Presence of viable bacteria in the blood. Evidence: TAS. Frequency: Occasional (HP:0040283). (ORPHA:544482)
- Anuria (HP:0100519): Absence of urine, clinically classified as below 50ml/day. Evidence: TAS. Frequency: Occasional (HP:0040283). (ORPHA:544482)
- Oliguria (HP:0100520): Low output of urine, clinically classified as an output below 300-500ml/day. Evidence: TAS. Frequency: Occasional (HP:0040283). (ORPHA:544482)
- Hypertensive crisis (HP:0100735). Evidence: TAS. Frequency: Occasional (HP:0040283). (ORPHA:544482)
- Diabetes mellitus (HP:0000819): A group of abnormalities characterized by hyperglycemia and glucose intolerance. Evidence: TAS. Frequency: Very rare (HP:0040284). (ORPHA:544482)
- Seizure (HP:0001250): A seizure is an intermittent abnormality of nervous system physiology characterized by a transient occurrence of signs and/or symptoms due to abnormal excessive or synchronous neuronal activity in the brain. Evidence: TAS. Frequency: Very rare (HP:0040284). (ORPHA:544482)
- Coma (HP:0001259): The complete absence of wakefulness and consciousness, which is evident through a lack of response to any form of external stimuli. Evidence: TAS. Frequency: Very rare (HP:0040284). (ORPHA:544482)
- Hemiparesis (HP:0001269): Loss of strength in the arm, leg, and sometimes face on one side of the body. Hemiplegia refers to a complete loss of strength, whereas hemiparesis refers to an incomplete loss of strength. Evidence: TAS. Frequency: Very rare (HP:0040284). (ORPHA:544482)
- Intussusception (HP:0002576): An abnormality of the intestine in which part of the intestine invaginates (telescopes) into another part of the intestine. Evidence: TAS. Frequency: Very rare (HP:0040284). (ORPHA:544482)
- Septic arthritis (HP:0003095). Evidence: TAS. Frequency: Very rare (HP:0040284). (ORPHA:544482)
- Gastrointestinal infarctions (HP:0005244). Evidence: TAS. Frequency: Very rare (HP:0040284). (ORPHA:544482)
- Generalized edema (HP:0007430): Generalized abnormal accumulation of fluid beneath the skin, or in one or more cavities of the body. Evidence: TAS. Frequency: Very rare (HP:0040284). (ORPHA:544482)
- Pleural empyema (HP:0011919): Accumulation of pus in the pleural cavity. Evidence: TAS. Frequency: Very rare (HP:0040284). (ORPHA:544482)
- Brain abscess (HP:0030049): A collection of pus, immune cells, and other material in the brain. Evidence: TAS. Frequency: Very rare (HP:0040284). (ORPHA:544482)
- Intestinal perforation (HP:0031368): A hole (perforation) in the wall of the intestine. Evidence: TAS. Frequency: Very rare (HP:0040284). (ORPHA:544482)
- Cerebral visual impairment (HP:0100704): A form of loss of vision caused by damage to the visual cortex rather than a defect in the eye. Evidence: TAS. Frequency: Very rare (HP:0040284). (ORPHA:544482)
These phenotypes are associated with the disease Infection-related hemolytic uremic syndrome (ORPHA:544482).